Phenotypes associated with the disease cone-rod dystrophy 11 (OMIM:610381):
- Slow decrease in visual acuity (HP:0007924). Evidence: TAS. (OMIM:610381)
- Pallor (HP:0000980): Abnormally pale skin. Evidence: IEA. (OMIM:610381)
- Macular degeneration (HP:0000608): A nonspecific term denoting degeneration of the retinal pigment epithelium and/or retinal photoreceptor cells of the macula lutea. Evidence: PCS. (PMID:15028672)
- Photophobia (HP:0000613): Excessive sensitivity to light with the sensation of discomfort or pain in the eyes due to exposure to bright light. Evidence: TAS. Frequency: Occasional (HP:0040283). (OMIM:610381)
- Cone/cone-rod dystrophy (HP:0000548). Evidence: PCS. (PMID:15028672)
- Macular atrophy (HP:0007401): A nonspecific term denoting wasting, especially as a result of degeneration, of the retinal pigment epithelium (RPE) and neurosensory retinal cells in the macula. Evidence: TAS. (OMIM:610381)
- Bull's eye maculopathy (HP:0011504): Progressive maculopathy characterized by concentric regions of hyper- and hypopigmentation, with an initial foveal sparing and whose appearance is said to resemble the central target of a dart board. Evidence: TAS. (OMIM:610381)
- Autosomal dominant inheritance (HP:0000006): A mode of inheritance that is observed for traits related to a gene encoded on one of the autosomes (i.e., the human chromosomes 1-22) in which a trait manifests in heterozygotes. In the context of medical genetics, an autosomal dominant disorder is caused when a single copy of the mutant allele is present. Males and females are affected equally, and can both transmit the disorder with a risk of 50% for each child of inheriting the mutant allele. Evidence: PCS. (PMID:15028672)